Phenotypes associated with the disease migraine with or without aura, susceptibility to, 12 (OMIM:611706):
- Vomiting (HP:0002013): Forceful ejection of the contents of the stomach through the mouth by means of a series of involuntary spasmic contractions. Evidence: TAS. (OMIM:611706)
- Migraine (HP:0002076): Migraine is a chronic neurological disorder characterized by episodic attacks of headache and associated symptoms. Evidence: IEA. (OMIM:611706)
- Photophobia (HP:0000613): Excessive sensitivity to light with the sensation of discomfort or pain in the eyes due to exposure to bright light. Evidence: TAS. (OMIM:611706)
- Phonophobia (HP:0002183): An abnormally heightened sensitivity to loud sounds. Evidence: TAS. (OMIM:611706)
- Nausea (HP:0002018): A sensation of unease in the stomach together with an urge to vomit. Evidence: TAS. (OMIM:611706)
- Headache (HP:0002315): Cephalgia, or pain sensed in various parts of the head, not confined to the area of distribution of any nerve. Evidence: TAS. (OMIM:611706)
- Autosomal dominant inheritance (HP:0000006): A mode of inheritance that is observed for traits related to a gene encoded on one of the autosomes (i.e., the human chromosomes 1-22) in which a trait manifests in heterozygotes. In the context of medical genetics, an autosomal dominant disorder is caused when a single copy of the mutant allele is present. Males and females are affected equally, and can both transmit the disorder with a risk of 50% for each child of inheriting the mutant allele. Evidence: TAS. (OMIM:611706)